Phenotypes associated with the disease Congenital respiratory-biliary fistula (ORPHA:2040):
- Abnormality of the liver (HP:0001392): An abnormality of the liver. Evidence: TAS. Frequency: Very frequent (HP:0040281). (ORPHA:2040)
- Tracheal stenosis (HP:0002777). Evidence: TAS. Frequency: Very frequent (HP:0040281). (ORPHA:2040)